- Microcephaly (HP:0000252): Head circumference below 2 standard deviations below the mean for age and gender. Evidence: TAS. Frequency: Very frequent (HP:0040281). (ORPHA:2319)
- Wide nose (HP:0000445): Interalar distance more than two standard deviations above the mean for age, i.e., an apparently increased width of the nasal base and alae. Evidence: TAS. Frequency: Very frequent (HP:0040281). (ORPHA:2319)
- Intrauterine growth retardation (HP:0001511): An abnormal restriction of fetal growth with fetal weight below the tenth percentile for gestational age. Evidence: TAS. Frequency: Very frequent (HP:0040281). (ORPHA:2319)
- Severe short stature (HP:0003510): A severe degree of short stature, more than -4 SD from the mean corrected for age and sex. Evidence: TAS. Frequency: Very frequent (HP:0040281). (ORPHA:2319)
- Hypospadias (HP:0000047): Abnormal position of urethral meatus on the ventral penile shaft (underside) characterized by displacement of the urethral meatus from the tip of the glans penis to the ventral surface of the penis, scrotum, or perineum. Evidence: TAS. Frequency: Frequent (HP:0040282). (ORPHA:2319)
- Horseshoe kidney (HP:0000085): A connection of the right and left kidney by an isthmus of functioning renal parenchyma or fibrous tissue that crosses the midline. Evidence: TAS. Frequency: Frequent (HP:0040282). (ORPHA:2319)
- Orofacial cleft (HP:0000202): The presence of a cleft (gap, opening, or groove) in the oral cavity, including cleft of the upper lip and/or cleft of the palate. Cleft of the upper lip is visible as a groove or fissure in the lip, most frequently due to a congenital failure of the maxillary and median nasal processes to fuse. Cleft palate is characterized by a grooved depression or fissure in the roof of the mouth, most often resulting from a congenital failure of the palate to fuse properly. Clefts of the lip and palate can occur individually or together. It is preferable to code each defect separately. Evidence: TAS. Frequency: Frequent (HP:0040282). (ORPHA:2319)
- Hypertelorism (HP:0000316): Interpupillary distance more than 2 SD above the mean (alternatively, the appearance of an increased interpupillary distance or widely spaced eyes). Evidence: TAS. Frequency: Frequent (HP:0040282). (ORPHA:2319)
- Abnormal eyebrow morphology (HP:0000534): An abnormality of the eyebrow. Evidence: TAS. Frequency: Frequent (HP:0040282). (ORPHA:2319)
- Abnormal rib morphology (HP:0000772): An anomaly of the rib. Evidence: TAS. Frequency: Frequent (HP:0040282). (ORPHA:2319)
- Abnormal finger morphology (HP:0001167): An anomaly of a finger. Evidence: TAS. Frequency: Frequent (HP:0040282). (ORPHA:2319)
- Intellectual disability (HP:0001249): The term intellectual disability or intellectual developmental disorder is used to describe significantly sub-average intellectual and adaptive functioning based on clinical assessment and as measured by individually administered, appropriately normed, standardized and validated tests of intellectual functioning and adaptive behavior, with onset during the developmental period from infancy through adolescence. Evidence: TAS. Frequency: Frequent (HP:0040282). (ORPHA:2319)
- Hammertoe (HP:0001765): Hyperextension of the metatarsal-phalangeal joint with hyperflexion of the proximal interphalangeal (PIP) joint. Evidence: TAS. Frequency: Frequent (HP:0040282). (ORPHA:2319)
- Toe syndactyly (HP:0001770): Webbing or fusion of the toes, involving soft parts only or including bone structure. Bony fusions are referred to as "bony" Syndactyly if the fusion occurs in a radio-ulnar axis. Fusions of bones of the toes in a proximo-distal axis are referred to as "Symphalangism". Evidence: TAS. Frequency: Frequent (HP:0040282). (ORPHA:2319)
- Highly arched eyebrow (HP:0002553): Increased height of the central portion of the eyebrow, forming a crescent, semicircular, or inverted U shape. Evidence: TAS. Frequency: Frequent (HP:0040282). (ORPHA:2319)
- Scoliosis (HP:0002650): The presence of an abnormal lateral curvature of the spine. Evidence: TAS. Frequency: Frequent (HP:0040282). (ORPHA:2319)
- Radioulnar synostosis (HP:0002974): An abnormal osseous union (fusion) between the radius and the ulna. Evidence: TAS. Frequency: Frequent (HP:0040282). (ORPHA:2319)
- Hypoplasia of the radius (HP:0002984): Underdevelopment of the radius. Evidence: TAS. Frequency: Frequent (HP:0040282). (ORPHA:2319)
- Abnormality of the wrist (HP:0003019): Abnormality of the wrist, the structure connecting the hand and the forearm. Evidence: TAS. Frequency: Frequent (HP:0040282). (ORPHA:2319)
- Abnormal vertebral morphology (HP:0003468): An abnormality of one or more of the vertebrae. Evidence: TAS. Frequency: Frequent (HP:0040282). (ORPHA:2319)
- Abnormal metacarpal morphology (HP:0005916): Any abnormal shape or structure of the metacarpal bones. Evidence: TAS. Frequency: Frequent (HP:0040282). (ORPHA:2319)
- Short thumb (HP:0009778): Hypoplasia (congenital reduction in size) of the thumb. Evidence: TAS. Frequency: Frequent (HP:0040282). (ORPHA:2319)
- Abnormality of the elbow (HP:0009811): An anomaly of the joint that connects the upper and the lower arm. Evidence: TAS. Frequency: Frequent (HP:0040282). (ORPHA:2319)
- Ptosis (HP:0000508): The upper eyelid margin is positioned 3 mm or more lower than usual and covers the superior portion of the iris (objective); or, the upper lid margin obscures at least part of the pupil (subjective). Evidence: TAS. Frequency: Occasional (HP:0040283). (ORPHA:2319)
- Dandy-Walker malformation (HP:0001305): A congenital brain malformation typically characterized by incomplete formation of the cerebellar vermis, dilation of the fourth ventricle, and enlargement of the posterior fossa. In layman's terms, Dandy Walker malformation is a cyst in the cerebellum (typically symmetrical) that is involved with the fourth ventricle. This may interfere with the ability to drain cerebrospinal fluid from the brain, resulting in hydrocephalus. Dandy Walker cysts are formed during early embryonic development, while the brain forms. The cyst in the cerebellum typically has several blood vessels running through it connecting to the brain, thereby prohibiting surgical removal. Evidence: TAS. Frequency: Occasional (HP:0040283). (ORPHA:2319)
- Anteriorly placed anus (HP:0001545): Anterior malposition of the anus. Evidence: TAS. Frequency: Occasional (HP:0040283). (ORPHA:2319)
These phenotypes are associated with the disease Juberg-Hayward syndrome (ORPHA:2319).